- Finger aplasia (HP:0009380): A developmental defect resulting in the presence of fewer than the normal number of fingers (i.e., aplasia of one or more fingers). Evidence: TAS. Frequency: Very frequent (HP:0040281). (ORPHA:3104)
- Glossoptosis (HP:0000162): Posterior displacement of the tongue into the pharynx, i.e., a tongue that is mislocalised posteriorly. Evidence: TAS. Frequency: Very frequent (HP:0040281). (ORPHA:3104)
- Micrognathia (HP:0000347): Developmental hypoplasia of the mandible. Evidence: TAS. Frequency: Very frequent (HP:0040281). (ORPHA:3104)
- Abnormal morphology of ulna (HP:0040071): Any structural anomaly of the ulna, a bone of the forearm the extends from the elbow to the little finger. Evidence: TAS. Frequency: Very frequent (HP:0040281). (ORPHA:3104)
- Abnormality of the dentition (HP:0000164): Any abnormality of the teeth. Evidence: TAS. Frequency: Frequent (HP:0040282). (ORPHA:3104)
- Cleft palate (HP:0000175): Cleft palate is a developmental defect of the palate resulting from a failure of fusion of the palatine processes and manifesting as a separation of the roof of the mouth (soft and hard palate). Evidence: TAS. Frequency: Frequent (HP:0040282). (ORPHA:3104)
- Narrow face (HP:0000275): Bizygomatic (upper face) and bigonial (lower face) width are both more than 2 standard deviations below the mean (objective); or, an apparent reduction in the width of the upper and lower face (subjective). Evidence: TAS. Frequency: Frequent (HP:0040282). (ORPHA:3104)
- Clinodactyly of the 5th finger (HP:0004209): Clinodactyly refers to a bending or curvature of the fifth finger in the radial direction (i.e., towards the 4th finger). Evidence: TAS. Frequency: Frequent (HP:0040282). (ORPHA:3104)
- Abnormal metacarpal morphology (HP:0005916): Any abnormal shape or structure of the metacarpal bones. Evidence: TAS. Frequency: Frequent (HP:0040282). (ORPHA:3104)
- Abnormal vertebral body morphology (HP:0003312): Abnormal form of vertebral body, which is the central cylindrical portion of the vertebra that together with other structures such as the vertebral arch, pedicles, laminae, spinous process, transverse processes, and articular facets makes up a vertebra. Evidence: TAS. Frequency: Occasional (HP:0040283). (ORPHA:3104)
These phenotypes are associated with the disease Robin sequence-oligodactyly syndrome (ORPHA:3104).